Phenotypes associated with the disease intellectual disability, X-linked 20 (OMIM:300047, an entry in Online Mendelian Inheritance in Man):
- X-linked inheritance (HP:0001417, a Human Phenotype Ontology term): A mode of inheritance that is observed for traits related to a gene encoded on the X chromosome. Evidence: IEA. (OMIM:300047)
- Intellectual disability (HP:0001249, a Human Phenotype Ontology term): The term intellectual disability or intellectual developmental disorder is used to describe significantly sub-average intellectual and adaptive functioning based on clinical assessment and as measured by individually administered, appropriately normed, standardized and validated tests of intellectual functioning and adaptive behavior, with onset during the developmental period from infancy through adolescence. Evidence: IEA. (OMIM:300047)